Phenotypes associated with the disease Johnson neuroectodermal syndrome (ORPHA:2316):
- Hypogonadism (HP:0000135): A decreased functionality of the gonad. Evidence: TAS. Frequency: Very frequent (HP:0040281). (ORPHA:2316)
- Conductive hearing impairment (HP:0000405): An abnormality of vibrational conductance of sound to the inner ear leading to impairment of sensory perception of sound. Evidence: TAS. Frequency: Very frequent (HP:0040281). (ORPHA:2316)
- Atresia of the external auditory canal (HP:0000413): Absence or failure to form of the external auditory canal. Evidence: TAS. Frequency: Very frequent (HP:0040281). (ORPHA:2316)
- Alopecia (HP:0001596): A noncongenital process of hair loss, which may progress to partial or complete baldness. Evidence: TAS. Frequency: Very frequent (HP:0040281). (ORPHA:2316)
- Sparse hair (HP:0008070): Reduced density of hairs. Evidence: TAS. Frequency: Very frequent (HP:0040281). (ORPHA:2316)
- Facial asymmetry (HP:0000324): An abnormal difference between the left and right sides of the face. Evidence: TAS. Frequency: Frequent (HP:0040282). (ORPHA:2316)
- Protruding ear (HP:0000411): Angle formed by the plane of the ear and the mastoid bone greater than the 97th centile for age (objective); or, outer edge of the helix more than 2 cm from the mastoid at the point of maximum distance (objective). Evidence: TAS. Frequency: Frequent (HP:0040282). (ORPHA:2316)
- Absent eyelashes (HP:0000561): Lack of eyelashes. Evidence: TAS. Frequency: Frequent (HP:0040282). (ORPHA:2316)
- Carious teeth (HP:0000670): Caries is a multifactorial bacterial infection affecting the structure of the tooth. This term has been used to describe the presence of more than expected dental caries. Evidence: TAS. Frequency: Frequent (HP:0040282). (ORPHA:2316)
- Intellectual disability (HP:0001249): The term intellectual disability or intellectual developmental disorder is used to describe significantly sub-average intellectual and adaptive functioning based on clinical assessment and as measured by individually administered, appropriately normed, standardized and validated tests of intellectual functioning and adaptive behavior, with onset during the developmental period from infancy through adolescence. Evidence: TAS. Frequency: Frequent (HP:0040282). (ORPHA:2316)
- Absent eyebrow (HP:0002223): Absence of the eyebrow. Evidence: TAS. Frequency: Frequent (HP:0040282). (ORPHA:2316)
- Severe short stature (HP:0003510): A severe degree of short stature, more than -4 SD from the mean corrected for age and sex. Evidence: TAS. Frequency: Frequent (HP:0040282). (ORPHA:2316)
- Microtia (HP:0008551): Underdevelopment of the external ear. Evidence: TAS. Frequency: Frequent (HP:0040282). (ORPHA:2316)
- Facial palsy (HP:0010628): Facial nerve palsy is a dysfunction of cranial nerve VII (the facial nerve) that results in inability to control facial muscles on the affected side with weakness of the muscles of facial expression and eye closure. This can either be present in unilateral or bilateral form. Evidence: TAS. Frequency: Frequent (HP:0040282). (ORPHA:2316)
- Cleft palate (HP:0000175): Cleft palate is a developmental defect of the palate resulting from a failure of fusion of the palatine processes and manifesting as a separation of the roof of the mouth (soft and hard palate). Evidence: TAS. Frequency: Occasional (HP:0040283). (ORPHA:2316)
- Everted lower lip vermilion (HP:0000232): An abnormal configuration of the lower lip such that it is turned outward i.e., everted, with the Inner aspect of the lower lip vermilion (normally opposing the teeth) being visible in a frontal view. Evidence: TAS. Frequency: Occasional (HP:0040283). (ORPHA:2316)
- Microcephaly (HP:0000252): Head circumference below 2 standard deviations below the mean for age and gender. Evidence: TAS. Frequency: Occasional (HP:0040283). (ORPHA:2316)
- Bulbous nose (HP:0000414): Increased volume and globular shape of the anteroinferior aspect of the nose. Evidence: TAS. Frequency: Occasional (HP:0040283). (ORPHA:2316)
- Choanal atresia (HP:0000453): Absence or abnormal closure of the choana (the posterior nasal aperture). Most embryologists believe that posterior choanal atresia results from a failure of rupture between the 35th and 38th day of fetal life of the partition which separates the bucconasal or buccopharyngeal membranes. The resultant choanal atresia may be unilateral or bilateral, bony or membranous, complete or incomplete. In over 90 per cent of cases the obstruction is bony, while in the remainder it is membranous. The bony type of atresia is commonly located 1-2 mm. anterior to the posterior edge of the hard palate, and the osseous septum varies in thickness from 1 to 10 mm. In the membranous form of choanal atresia the obstruction usually occurs further posteriorly. In approximately one third of cases the atresia is bilateral. Evidence: TAS. Frequency: Occasional (HP:0040283). (ORPHA:2316)
- Anosmia (HP:0000458): An inability to perceive odors. This is a general term describing inability to smell arising in any part of the process of smelling from absorption of odorants into the nasal mucous overlying the olfactory epithelium, diffusion to the cilia, binding to olfactory receptor sites, generation of action potentials in olfactory neurons, and perception of a smell. Evidence: TAS. Frequency: Occasional (HP:0040283). (ORPHA:2316)
- Downslanted palpebral fissures (HP:0000494): The palpebral fissure inclination is more than two standard deviations below the mean. Evidence: TAS. Frequency: Occasional (HP:0040283). (ORPHA:2316)
- Hypohidrosis (HP:0000966): Abnormally diminished capacity to sweat. Evidence: TAS. Frequency: Occasional (HP:0040283). (ORPHA:2316)
- Hand polydactyly (HP:0001161): A kind of polydactyly characterized by the presence of a supernumerary finger or fingers. Evidence: TAS. Frequency: Occasional (HP:0040283). (ORPHA:2316)
- Preaxial hand polydactyly (HP:0001177): Supernumerary digits located at the radial side of the hand. Polydactyly (supernumerary digits) involving the thumb occurs in many distinct forms of high variability and severity. Ranging from fleshy nubbins over varying degrees of partial duplication/splitting to completely duplicated or even triplicated thumbs or preaxial (on the radial side of the hand) supernumerary digits. Evidence: TAS. Frequency: Occasional (HP:0040283). (ORPHA:2316)
- Failure to thrive (HP:0001508): Failure to thrive (FTT) refers to a child whose physical growth is substantially below the norm. Evidence: TAS. Frequency: Occasional (HP:0040283). (ORPHA:2316)
- Tetralogy of Fallot (HP:0001636): A congenital cardiac malformation comprising pulmonary stenosis, overriding aorta, ventricular septum defect, and right ventricular hypertrophy. The diagnosis of TOF is made if at least three of the four above mentioned features are present. Evidence: TAS. Frequency: Occasional (HP:0040283). (ORPHA:2316)
- Multiple cafe-au-lait spots (HP:0007565): The presence of six or more cafe-au-lait spots. Evidence: TAS. Frequency: Occasional (HP:0040283). (ORPHA:2316)